Phenotypes associated with the disease anterior segment dysgenesis 6 (OMIM:617315):
- Corneal opacity (HP:0007957): A reduction of corneal clarity. Evidence: PCS. (PMID:11403040)
- Abnormal Descemet membrane morphology (HP:0011490): Abnormality of Descemet's membrane, which is the basement membrane of the corneal endothelium. Evidence: PCS. (PMID:11403040)
- Corneal neovascularization (HP:0011496): Ingrowth of new blood vessels into the cornea. Evidence: PCS. (PMID:11403040)
- Developmental glaucoma (HP:0001087): Glaucoma which forms during the early years of a child's life is called developmental or congenital glaucoma. Evidence: PCS. (PMID:11403040)
- Posterior synechiae of the anterior chamber (HP:0011484): Adhesions between the iris and the lens. Evidence: PCS. (PMID:11403040)
- Autosomal recessive inheritance (HP:0000007): A mode of inheritance that is observed for traits related to a gene encoded on one of the autosomes (i.e., the human chromosomes 1-22) in which a trait manifests in individuals with two pathogenic alleles, either homozygotes (two copies of the same mutant allele) or compound heterozygotes (whereby each copy of a gene has a distinct mutant allele). Evidence: PCS. (PMID:27839872)